Phenotypes associated with the disease neurodevelopmental disorder with cerebellar hypoplasia and spasticity (OMIM:618572):
- Microcephaly (HP:0000252): Head circumference below 2 standard deviations below the mean for age and gender. Evidence: PCS. Frequency: 3/3. (PMID:28542170)
- Inability to walk (HP:0002540): Incapability to ambulate. Evidence: PCS. Frequency: 3/3. (PMID:28542170)
- Absent speech (HP:0001344): Complete lack of development of speech and language abilities. Evidence: PCS. Frequency: 3/3. (PMID:28542170)
- Prominent glabella (HP:0002057): Forward protrusion of the glabella. Evidence: PCS. Frequency: 3/3. (PMID:28542170)
- Short stature (HP:0004322): A height below that which is expected according to age and gender norms. Although there is no universally accepted definition of short stature, many refer to "short stature" as height more than 2 standard deviations below the mean for age and gender (or below the 3rd percentile for age and gender dependent norms). Evidence: PCS. Frequency: 2/2. (PMID:28542170)
- Cerebellar hypoplasia (HP:0001321): Cerebellar hypoplasia is a descriptive term implying a cerebellum with a reduced volume, but a normal shape and is stable over time. Evidence: PCS. Frequency: 3/3. (PMID:28542170)
- Seizure (HP:0001250): A seizure is an intermittent abnormality of nervous system physiology characterized by a transient occurrence of signs and/or symptoms due to abnormal excessive or synchronous neuronal activity in the brain. Evidence: PCS. Frequency: 3/3. (PMID:28542170)
- Global developmental delay (HP:0001263): A delay in the achievement of motor or mental milestones in the domains of development of a child, including motor skills, speech and language, cognitive skills, and social and emotional skills. This term should only be used to describe children younger than five years of age. Evidence: PCS. Frequency: 3/3. (PMID:28542170)
- Periventricular nodular heterotopia (HP:0032388): Nodules of heterotopia along the ventricular walls. There can be a single nodule or a large number of nodules, they can exist on either or both sides of the brain at any point along the higher ventricle margins, they can be small or large, single or multiple. Evidence: PCS. Frequency: 3/3. (PMID:28542170)
- Hypertelorism (HP:0000316): Interpupillary distance more than 2 SD above the mean (alternatively, the appearance of an increased interpupillary distance or widely spaced eyes). Evidence: PCS. Frequency: 2/3. (PMID:28542170)
- Overlapping toe (HP:0001845): Describes a foot digit resting on the dorsal surface of an adjacent digit when the foot is at rest. Initially clawing may be dynamic and only noticeable on walking. Over time the plantar plate tears, subluxation occurs at the metatarsophalangeal joint (MTPJ), and the deformity becomes permanent. Evidence: PCS. Frequency: 3/3. (PMID:28542170)
- Autosomal recessive inheritance (HP:0000007): A mode of inheritance that is observed for traits related to a gene encoded on one of the autosomes (i.e., the human chromosomes 1-22) in which a trait manifests in individuals with two pathogenic alleles, either homozygotes (two copies of the same mutant allele) or compound heterozygotes (whereby each copy of a gene has a distinct mutant allele). Evidence: PCS. (PMID:28542170)
- Optic atrophy (HP:0000648): Atrophy of the optic nerve. Optic atrophy results from the death of the retinal ganglion cell axons that comprise the optic nerve and manifesting as a pale optic nerve on fundoscopy. Evidence: PCS. Frequency: 2/3. (PMID:28542170)
- Spastic paraplegia (HP:0001258): Complete loss of the ability to move the lower limbs accompanied by spasticity of the lower limbs. Evidence: PCS. Frequency: 3/3. (PMID:28542170)